- Narrow forehead (HP:0000341): Width of the forehead or distance between the frontotemporales is more than two standard deviations below the mean (objective); or apparently narrow intertemporal region (subjective). Evidence: PCS. Frequency: 1/6. (PMID:33833410)
- Epicanthus (HP:0000286): A fold of skin starting above the medial aspect of the upper eyelid and arching downward to cover, pass in front of and lateral to the medial canthus. Evidence: PCS. Frequency: 2/6. (PMID:33833410)
- Upslanted palpebral fissure (HP:0000582): The palpebral fissure inclination is more than two standard deviations above the mean for age (objective); or, the inclination of the palpebral fissure is greater than typical for age. Evidence: PCS. Frequency: 4/6. (PMID:33833410)
- Astigmatism (HP:0000483): A type of refraction error associated with abnormal curvatures on the anterior and/or posterior surface of the cornea. Evidence: PCS. Frequency: 1/6. (PMID:33833410)
- Congenital onset (HP:0003577): A phenotypic abnormality that is present at birth. Evidence: PCS. Frequency: 3/6. (PMID:33833410)
- Brachydactyly (HP:0001156): Digits that appear disproportionately short compared to the hand/foot. The word brachydactyly is used here to describe a series distinct patterns of shortened digits (brachydactyly types A-E). This is the sense used here. Evidence: PCS. Frequency: 1/6. (PMID:33833410)
- Seizure (HP:0001250): A seizure is an intermittent abnormality of nervous system physiology characterized by a transient occurrence of signs and/or symptoms due to abnormal excessive or synchronous neuronal activity in the brain. Evidence: PCS. Frequency: 1/6. (PMID:33833410)
- Infantile onset (HP:0003593): Onset of signs or symptoms of disease between 28 days to one year of life. Evidence: PCS. Frequency: 3/6. (PMID:33833410)
- Short palpebral fissure (HP:0012745): Distance between the medial and lateral canthi is more than 2 SD below the mean for age (objective); or, apparently reduced length of the palpebral fissures. Evidence: PCS. Frequency: 1/6. (PMID:33833410)
- Happy demeanor (HP:0040082): A conspicuously happy disposition, characterized by frequent smiling and laughing, which may be contextually inappropriate or unrelated to the situation. Evidence: PCS. Frequency: 1/6. (PMID:33833410)
- Aggressive behavior (HP:0000718): Behavior or an act aimed at harming a person, animal, or physical property (e.g., acts of physical violence; shouting, swearing, and using harsh language; slashing someone's tires). Evidence: PCS. Frequency: 3/6. (PMID:33833410)
- Thin upper lip vermilion (HP:0000219): Height of the vermilion of the upper lip in the midline more than 2 SD below the mean. Alternatively, an apparently reduced height of the vermilion of the upper lip in the frontal view (subjective). Evidence: PCS. Frequency: 1/6. (PMID:33833410)
- Downturned corners of mouth (HP:0002714): A morphological abnormality of the mouth in which the angle of the mouth is downturned. The oral commissures are positioned inferior to the midline labial fissure. Evidence: PCS. Frequency: 1/6. (PMID:33833410)
- Broad nasal tip (HP:0000455): Increase in width of the nasal tip. Evidence: PCS. Frequency: 1/6. (PMID:33833410)
- Round face (HP:0000311): The facial appearance is more circular than usual as viewed from the front. Evidence: PCS. Frequency: 1/6. (PMID:33833410)
- Posteriorly rotated ears (HP:0000358): A type of abnormal location of the ears in which the position of the ears is characterized by posterior rotation (the superior part of the ears is rotated towards the back of the head, and the inferior part of the ears towards the front). Evidence: PCS. Frequency: 1/6. (PMID:33833410)
- Torticollis (HP:0000473): Involuntary contractions of the neck musculature resulting in an abnormal posture of or abnormal movements of the head. Evidence: PCS. Frequency: 1/6. (PMID:33833410)
- Submucous cleft hard palate (HP:0000176): Hard-palate submucous clefts are characterized by bony defects in the midline of the bony palate that are covered by the mucous membrane of the roof of the mouth. It may be possible to detect a submucous cleft hard palate upon palpation as a notch in the bony palate. Evidence: PCS. Frequency: 1/6. (PMID:33833410)
- Microcephaly (HP:0000252): Head circumference below 2 standard deviations below the mean for age and gender. Evidence: PCS. Frequency: 1/6. (PMID:33833410)
- Delayed speech and language development (HP:0000750): A degree of language development that is significantly below the norm for a child of a specified age. Evidence: PCS. Frequency: 6/6. (PMID:33833410)
- Obstructive sleep apnea (HP:0002870): Obstructive Sleep Apnea is a condition characterized by the obstruction of the airway and pauses in breathing during sleep, which occur multiple times throughout the night. It is related to the relaxation of muscle tone that typically happens during sleep, leading to a partial collapse of the soft tissues in the airway and causing airflow obstruction. Evidence: PCS. Frequency: 2/6. (PMID:33833410)
- Global developmental delay (HP:0001263): A delay in the achievement of motor or mental milestones in the domains of development of a child, including motor skills, speech and language, cognitive skills, and social and emotional skills. This term should only be used to describe children younger than five years of age. Evidence: PCS. Frequency: 6/6. (PMID:33833410)
- Tapered finger (HP:0001182): The gradual reduction in girth of the finger from proximal to distal. Evidence: PCS. Frequency: 1/6. (PMID:33833410)
- Hemidystonia (HP:0032005): Hemidystonia refers to dystonia which involves the ipsilateral face, arm, and leg. Evidence: PCS. Frequency: 1/6. (PMID:33833410)
- Depressed nasal bridge (HP:0005280): Posterior positioning of the nasal root in relation to the overall facial profile for age. Evidence: PCS. Frequency: 1/6. (PMID:33833410)
- Recurrent hand flapping (HP:0100023): A type of repetitive behavior in which the affected individual repeatedly waves the hands and/or arms rhythmically. Evidence: PCS. Frequency: 1/6. (PMID:33833410)
- Enuresis nocturna (HP:0010677): Enuresis occurring during sleeping hours. Evidence: PCS. Frequency: 1/6. (PMID:33833410)
- Sensory seeking (HP:4000079): Unusual interest in sensory aspects of the environment. Evidence: PCS. Frequency: 1/6. (PMID:33833410)
- Autistic behavior (HP:0000729): Persistent deficits in social interaction and communication and interaction as well as a markedly restricted repertoire of activity and interest as well as repetitive patterns of behavior. Evidence: PCS. Frequency: 6/6. (PMID:33833410)
- Speech apraxia (HP:0011098): A type of apraxia that is characterized by difficulty or inability to execute speech movements because of problems with coordination and motor problems, leading to incorrect articulation. An increase of errors with increasing word and phrase length may occur. Evidence: PCS. Frequency: 6/6. (PMID:33833410)
- Hypotelorism (HP:0000601): Interpupillary distance less than 2 SD below the mean (alternatively, the appearance of an decreased interpupillary distance or closely spaced eyes). Evidence: PCS. Frequency: 1/6. (PMID:33833410)
- Recurrent otitis media (HP:0000403): Increased susceptibility to otitis media, as manifested by recurrent episodes of otitis media. Evidence: PCS. Frequency: 1/6. (PMID:33833410)
- Neonatal hypotonia (HP:0001319): Muscular hypotonia (abnormally low muscle tone) manifesting in the neonatal period. Evidence: PCS. Frequency: 3/3. Onset: Congenital onset (HP:0003577). (PMID:33833410)
- Esotropia (HP:0000565): A form of strabismus with one or both eyes turned inward ('crossed') to a relatively severe degree, usually defined as 10 diopters or more. Evidence: PCS. Frequency: 1/6. (PMID:33833410)
- Plagiocephaly (HP:0001357): Asymmetric head shape, which is usually a combination of unilateral occipital flattening with ipsilateral frontal prominence, leading to rhomboid cranial shape. Evidence: PCS. Frequency: 1/6. (PMID:33833410)
- Attention deficit hyperactivity disorder (HP:0007018): Attention deficit hyperactivity disorder (ADHD) manifests at age 2-3 years or by first grade at the latest. The main symptoms are distractibility, impulsivity, hyperactivity, and often trouble organizing tasks and projects, difficulty going to sleep, and social problems from being aggressive, loud, or impatient. Evidence: PCS. Frequency: 5/5. (PMID:33833410)
- Autosomal dominant inheritance (HP:0000006): A mode of inheritance that is observed for traits related to a gene encoded on one of the autosomes (i.e., the human chromosomes 1-22) in which a trait manifests in heterozygotes. In the context of medical genetics, an autosomal dominant disorder is caused when a single copy of the mutant allele is present. Males and females are affected equally, and can both transmit the disorder with a risk of 50% for each child of inheriting the mutant allele. Evidence: PCS. (PMID:33833410)
- Tremor (HP:0001337): An unintentional, oscillating to-and-fro muscle movement about a joint axis. Evidence: PCS. Frequency: 1/6. (PMID:33833410)
- Obesity (HP:0001513): Accumulation of substantial excess body fat. Evidence: PCS. Frequency: 1/6. (PMID:33833410)
These phenotypes are associated with the disease Marbach-Schaaf neurodevelopmental syndrome (OMIM:619680).